Phenotypes associated with the disease Chromomycosis (ORPHA:182):
- Pruritus (HP:0000989): Pruritus is an itch or a sensation that makes a person want to scratch. This term refers to an abnormally increased disposition to experience pruritus. Evidence: TAS. Frequency: Very frequent (HP:0040281). (ORPHA:182)
- Abnormality of the lower limb (HP:0002814): An abnormality of the leg. Evidence: TAS. Frequency: Very frequent (HP:0040281). (ORPHA:182)
- Hyperkeratosis (HP:0000962): Hyperkeratosis is a histopathological term defining a thickened stratum corneum and may be present in many different skin conditions, with many possible overlaps. Hyperkeratosis refers to the increased thickness of the stratum corneum, the outer layer of the skin. Hyperkeratosis is subclassified as orthokeratotic or parakeratotic. Orthokeratotic hyperkeratosis refers to the thickening of the keratin layer with preserved keratinocyte maturation, while parakeratotic hyperkeratosis shows retained nuclei as a sign of delayed maturation of keratinocytes. Evidence: TAS. Frequency: Frequent (HP:0040282). (ORPHA:182)
- Edema (HP:0000969): An abnormal accumulation of fluid beneath the skin, or in one or more cavities of the body. Evidence: TAS. Frequency: Frequent (HP:0040282). (ORPHA:182)
- Lymphedema (HP:0001004): Localized fluid retention and tissue swelling caused by a compromised lymphatic system. Evidence: TAS. Frequency: Frequent (HP:0040282). (ORPHA:182)
- Subcutaneous nodule (HP:0001482): Slightly elevated lesions on or in the skin with a diameter of over 5 mm. Evidence: TAS. Frequency: Frequent (HP:0040282). (ORPHA:182)
- Abnormal foot morphology (HP:0001760): An abnormality of the skeleton of foot. Evidence: TAS. Frequency: Frequent (HP:0040282). (ORPHA:182)
- Predominantly lower limb lymphedema (HP:0003550): Localized fluid retention and tissue swelling caused by a compromised lymphatic system, affecting mainly the legs. Evidence: TAS. Frequency: Frequent (HP:0040282). (ORPHA:182)
- Verrucous papule (HP:0012500): A wartlike (with multiple small elevated projections) papule. Evidence: TAS. Frequency: Frequent (HP:0040282). (ORPHA:182)
- Erythematous plaque (HP:0025474): A plaque (a solid, raised, plateau-like (flat-topped) lesion greater than 1 cm in diameter) with a red or reddish color often associated with inflammation or irritation. Evidence: TAS. Frequency: Frequent (HP:0040282). (ORPHA:182)
- Erythematous macule (HP:0025475): A macule (flat, distinct, discolored area of skin less than 1 cm wide that does not involve any change in the thickness or texture of the skin) with a red or reddish color often associated with inflammation or irritation. Evidence: TAS. Frequency: Frequent (HP:0040282). (ORPHA:182)
- Serpiginous cutaneous lesion (HP:0025527): A skin lesion with a snake- or serpent-like distribution. Evidence: TAS. Frequency: Frequent (HP:0040282). (ORPHA:182)
- Annular cutaneous lesion (HP:0025528): A lesion of the skin with a ring-like distribution. Evidence: TAS. Frequency: Frequent (HP:0040282). (ORPHA:182)
- Hyperparakeratosis (HP:0040009): Histological term to illustrate the combined presence of parakeratosis and hyperkeratosis. Abnormal keratinization of the epidermal stratum corneum (horny layer) with increased keratin formation and preservation of the nuclei in the superficial cells. Evidence: TAS. Frequency: Frequent (HP:0040282). (ORPHA:182)
- Hyperkeratotic papule (HP:0045059): A circumscribed, solid elevation of skin with no visible fluid, varying in size from a pinhead to less than 10mm in diameter at the widest point that is composed of localized hyperkeratosis (the latter may be demonstrated histopathologically). Evidence: TAS. Frequency: Frequent (HP:0040282). (ORPHA:182)
- Atypical scarring of skin (HP:0000987): Atypically scarred skin . Evidence: TAS. Frequency: Occasional (HP:0040283). (ORPHA:182)
- Hypopigmented skin patches (HP:0001053). Evidence: TAS. Frequency: Occasional (HP:0040283). (ORPHA:182)
- Recurrent bacterial infections (HP:0002718): Increased susceptibility to bacterial infections as manifested by recurrent episodes of bacterial infection. Evidence: TAS. Frequency: Occasional (HP:0040283). (ORPHA:182)
- Abnormality of the upper limb (HP:0002817): An abnormality of the arm. Evidence: TAS. Frequency: Occasional (HP:0040283). (ORPHA:182)
- Vascular skin abnormality (HP:0011276). Evidence: TAS. Frequency: Occasional (HP:0040283). (ORPHA:182)
- Lymphangiectasis (HP:0031842): Dilation of the lymphatic vessels, the basic process that may result in the formation of a lymphangioma. Evidence: TAS. Frequency: Occasional (HP:0040283). (ORPHA:182)
- Abnormal oral cavity morphology (HP:0000163): Abnormality of the oral cavity, i.e., the opening or hollow part of the mouth. Evidence: TAS. Frequency: Very rare (HP:0040284). (ORPHA:182)
- Keratitis (HP:0000491): Inflammation of the cornea. Evidence: TAS. Frequency: Very rare (HP:0040284). (ORPHA:182)
- Ectropion (HP:0000656): An outward turning (eversion) or rotation of the eyelid margin. Evidence: TAS. Frequency: Very rare (HP:0040284). (ORPHA:182)
- Keratoconjunctivitis sicca (HP:0001097): Dryness of the eye related to deficiency of the tear film components (aqueous, mucin, or lipid), lid surface abnormalities, or epithelial abnormalities. Keratoconjunctivitis sicca often results in a scratchy or sandy sensation (foreign body sensation) in the eyes, and may also be associated with itching, inability to produce tears, photosensitivity, redness, pain, and difficulty in moving the eyelids. Evidence: TAS. Frequency: Very rare (HP:0040284). (ORPHA:182)
- Abnormal lung morphology (HP:0002088): Any structural anomaly of the lung. Evidence: TAS. Frequency: Very rare (HP:0040284). (ORPHA:182)
- Immunodeficiency (HP:0002721): Failure of the immune system to protect the body adequately from infection, due to the absence or insufficiency of some component process or substance. Evidence: TAS. Frequency: Very rare (HP:0040284). (ORPHA:182)
- Osteolysis (HP:0002797): Osteolysis refers to the destruction of bone through bone resorption with removal or loss of calcium. Evidence: TAS. Frequency: Very rare (HP:0040284). (ORPHA:182)
- Squamous cell carcinoma (HP:0002860): The presence of squamous cell carcinoma of the skin. Evidence: TAS. Frequency: Very rare (HP:0040284). (ORPHA:182)
- Multiple cutaneous malignancies (HP:0007606). Evidence: TAS. Frequency: Very rare (HP:0040284). (ORPHA:182)
- Facial shape deformation (HP:0011334). Evidence: TAS. Frequency: Very rare (HP:0040284). (ORPHA:182)
- Ankylosis (HP:0031013): A reduction of joint mobility resulting from changes involving the articular surfaces. Evidence: TAS. Frequency: Very rare (HP:0040284). (ORPHA:182)
- Eyelid retraction (HP:0500043): With the eyes in primary position, the sclera is visible above the superior corneal limbus. Evidence: TAS. Frequency: Very rare (HP:0040284). (ORPHA:182)